- Avascular necrosis (HP:0010885): A disease where there is cellular death (necrosis) of bone components due to interruption of the blood supply. Evidence: TAS. Frequency: Very frequent (HP:0040281). (ORPHA:399180)
- Limitation of joint mobility (HP:0001376): A reduction in the freedom of movement of one or more joints. Evidence: TAS. Frequency: Frequent (HP:0040282). (ORPHA:399180)
- Bone pain (HP:0002653): An unpleasant sensation characterized by physical discomfort (such as pricking, throbbing, or aching) localized to bone. Evidence: TAS. Frequency: Frequent (HP:0040282). (ORPHA:399180)
- Autoimmunity (HP:0002960): The occurrence of an immune reaction against the organism's own cells or tissues. Evidence: TAS. Frequency: Frequent (HP:0040282). (ORPHA:399180)
- Addictive alcohol use (HP:0030955): An addictive behavior is defined as drinking excessive amounts of alcohol over a prolonged period of time, having difficulty in reducing the amount of alcohol consumed, strongly desiring alcohol, and experiencing withdrawal symptoms when not drinking alcohol. Evidence: TAS. Frequency: Frequent (HP:0040282). (ORPHA:399180)
- Gait disturbance (HP:0001288): The term gait disturbance can refer to any disruption of the ability to walk. Evidence: TAS. Frequency: Occasional (HP:0040283). (ORPHA:399180)
- Rheumatoid arthritis (HP:0001370): Inflammatory changes in the synovial membranes and articular structures with widespread fibrinoid degeneration of the collagen fibers in mesenchymal tissues, as well as atrophy and rarefaction of bony structures. Evidence: TAS. Frequency: Occasional (HP:0040283). (ORPHA:399180)
- Neoplasm (HP:0002664): An organ or organ-system abnormality that consists of uncontrolled autonomous cell-proliferation which can occur in any part of the body as a benign or malignant neoplasm (tumor). Evidence: TAS. Frequency: Occasional (HP:0040283). (ORPHA:399180)
- Systemic lupus erythematosus (HP:0002725): A chronic, relapsing, inflammatory, and often febrile multisystemic disorder of connective tissue, characterized principally by involvement of the skin, joints, kidneys, and serosal membranes. Evidence: TAS. Frequency: Occasional (HP:0040283). (ORPHA:399180)
- Abnormality of connective tissue (HP:0003549): Any abnormality of the soft tissues, including both connective tissue (tendons, ligaments, fascia, fibrous tissues, and fat). Evidence: TAS. Frequency: Occasional (HP:0040283). (ORPHA:399180)
- Hematological neoplasm (HP:0004377): Neoplasms located in the blood and blood-forming tissue (the bone marrow and lymphatic tissue). Evidence: TAS. Frequency: Occasional (HP:0040283). (ORPHA:399180)
- Groin pain (HP:0031520): An unpleasant sensation characterized by physical discomfort (such as pricking, throbbing, or aching) localized to the groin region. Evidence: TAS. Frequency: Occasional (HP:0040283). (ORPHA:399180)
- Hypercoagulability (HP:0100724): An abnormality of coagulation associated with an increased risk of thrombosis. Evidence: TAS. Frequency: Very rare (HP:0040284). (ORPHA:399180)
These phenotypes are associated with the disease Secondary non-traumatic avascular necrosis (ORPHA:399180).